- Autosomal recessive inheritance (HP:0000007): A mode of inheritance that is observed for traits related to a gene encoded on one of the autosomes (i.e., the human chromosomes 1-22) in which a trait manifests in individuals with two pathogenic alleles, either homozygotes (two copies of the same mutant allele) or compound heterozygotes (whereby each copy of a gene has a distinct mutant allele). Evidence: TAS. (OMIM:614344)
- Motor delay (HP:0001270): A type of Developmental delay characterized by a delay in acquiring motor skills. Evidence: TAS. (OMIM:614344)
- Severe intellectual disability (HP:0010864): Severe intellectual disability (ID) is defined as a type of ID characterized by severely sub-average adaptive functioning and intellectual functioning, with an intelligence quotient (IQ) the range of 20-34. Evidence: TAS. (OMIM:614344)
These phenotypes are associated with the disease intellectual disability, autosomal recessive 23 (OMIM:614344).